- Permanent atrial fibrillation (HP:0004754): Atrial fibrillation (AF) that cannot be successfully terminated by cardioversion, and longstanding (more than 1 year) AF, where cardioversion is not indicated or has not been attempted, is termed permanent. Evidence: PCS. Frequency: 9/19. (PMID:23264583;PMID:19343045)
- Middle age onset (HP:0003596): A type of adult onset with onset of symptoms at the age of 40 to 60 years. Evidence: PCS. Frequency: 2/3. (PMID:16772329)
- Early young adult onset (HP:0025708): Onset of disease at an age of greater than or equal to 16 to under 19 years. Evidence: PCS. Frequency: 2/2. (PMID:23264583)
- Prolonged QTc interval (HP:0005184): A longer than normal interval (corrected for heart rate) between the Q and T waves in the heart's cycle. Prolonged QTc can cause premature action potentials during late phase depolarizations thereby leading to ventricular arrhythmias and ventricular fibrillations. Evidence: PCS. Frequency: 1/2. (PMID:23264583)
- Late young adult onset (HP:0025710): Onset of disease at an age of greater than or equal to 25 to under 40 years. Evidence: PCS. Frequency: 1/3. (PMID:16772329)
- Palpitations (HP:0001962): A sensation that the heart is pounding or racing, which is a non-specific sign but may be a manifestation of arrhythmia. Evidence: PCS. Frequency: 29/31. (PMID:16772329;PMID:19343045)
- Paroxysmal atrial fibrillation (HP:0004757): Episodes of atrial fibrillation that typically last for several hours up to one day and terminate spontaneously. Evidence: PCS. Frequency: 12/22. (PMID:16772329;PMID:23264583;PMID:19343045)
- Premature atrial contractions (HP:0006699): A type of cardiac arrhythmia with premature atrial contractions or beats caused by signals originating from ectopic atrial sites. Evidence: PCS. Frequency: 16/20. (PMID:19343045)
- Autosomal dominant inheritance (HP:0000006): A mode of inheritance that is observed for traits related to a gene encoded on one of the autosomes (i.e., the human chromosomes 1-22) in which a trait manifests in heterozygotes. In the context of medical genetics, an autosomal dominant disorder is caused when a single copy of the mutant allele is present. Males and females are affected equally, and can both transmit the disorder with a risk of 50% for each child of inheriting the mutant allele. Evidence: PCS. (PMID:16772329)
- Prolonged PR interval (HP:0012248): Increased time for the PR interval (beginning of the P wave to the beginning of the QRS complex). Evidence: PCS. Frequency: 1/2. (PMID:23264583)
- Sinus bradycardia (HP:0001688): Bradycardia related to a mean resting sinus rate of less than 50 beats per minute. Evidence: PCS. Frequency: 3/21. (PMID:19343045)
These phenotypes are associated with the disease atrial fibrillation, familial, 7 (OMIM:612240).